Phenotypes associated with the disease chromosome 3q29 microdeletion syndrome (DECIPHER:37):
- Long face (HP:0000276): Facial height (length) is more than 2 standard deviations above the mean (objective); or, an apparent increase in the height (length) of the face (subjective). Evidence: IEA. (DECIPHER:37)
- Prominent nasal bridge (HP:0000426): Anterior positioning of the nasal root in comparison to the usual positioning for age. Evidence: IEA. (DECIPHER:37)
- Short philtrum (HP:0000322): Distance between nasal base and midline upper lip vermilion border more than 2 SD below the mean. Alternatively, an apparently decreased distance between nasal base and midline upper lip vermilion border. Evidence: IEA. (DECIPHER:37)
- Intellectual disability (HP:0001249): The term intellectual disability or intellectual developmental disorder is used to describe significantly sub-average intellectual and adaptive functioning based on clinical assessment and as measured by individually administered, appropriately normed, standardized and validated tests of intellectual functioning and adaptive behavior, with onset during the developmental period from infancy through adolescence. Evidence: IEA. (DECIPHER:37)